- Constriction of peripheral visual field (HP:0001133): An absolute or relative decrease in retinal sensitivity extending from edge (periphery) of the visual field in a concentric pattern. The visual field is the area that is perceived simultaneously by a fixating eye. Evidence: TAS. (OMIM:180104)
- Spicular pigmentation of the retina (HP:0007737): Pigment migration into the retina in a bone-spicule configuration (resembling the nucleated cells within the lacuna of bone). Evidence: TAS. (OMIM:180104)
- Nyctalopia (HP:0000662): Inability to see well at night or in poor light. Evidence: TAS. (OMIM:180104)
- Macular edema (HP:0040049): Thickening of the retina that takes place due to accumulation of extracellular fluid in the macula as a nonspecific response to blood-retinal barrier breakdown. It can either have a cystoid aspect in the fovea, or a more diffuse aspect. Evidence: TAS. Frequency: Occasional (HP:0040283). (OMIM:180104)
- Cataract (HP:0000518): A cataract is an opacity or clouding that develops in the crystalline lens of the eye or in its capsule. Evidence: TAS. Frequency: Occasional (HP:0040283). (OMIM:180104)
- Macular atrophy (HP:0007401): A nonspecific term denoting wasting, especially as a result of degeneration, of the retinal pigment epithelium (RPE) and neurosensory retinal cells in the macula. Evidence: TAS. Frequency: Occasional (HP:0040283). (OMIM:180104)
- Rod-cone dystrophy (HP:0000510): An inherited retinal disease subtype in which the rod photoreceptors appear to be more severely affected than the cone photoreceptors. Typical presentation is with nyctalopia (due to rod dysfunction) followed by loss of mid-peripheral field of vision, which gradually extends and leaves many patients with a small central island of vision due to the preservation of macular cones. Evidence: TAS. (OMIM:180104)
- Undetectable light- and dark-adapted electroretinogram (HP:0007688): Absence of the combined rod-and-cone response on electroretinogram. Evidence: TAS. (OMIM:180104)
- Autosomal dominant inheritance (HP:0000006): A mode of inheritance that is observed for traits related to a gene encoded on one of the autosomes (i.e., the human chromosomes 1-22) in which a trait manifests in heterozygotes. In the context of medical genetics, an autosomal dominant disorder is caused when a single copy of the mutant allele is present. Males and females are affected equally, and can both transmit the disorder with a risk of 50% for each child of inheriting the mutant allele. Evidence: PCS. (PMID:12032732)
These phenotypes are associated with the disease retinitis pigmentosa 9 (OMIM:180104).